- Hyperostosis frontalis interna (HP:0004438): Bony overgrowth of the internal (endosteal) surface of the frontal bone. Evidence: TAS. Frequency: Obligate (HP:0040280). (ORPHA:77296)
- Abnormality of the nervous system (HP:0000707): An abnormality of the nervous system. Evidence: TAS. Frequency: Very frequent (HP:0040281). (ORPHA:77296)
- Atypical behavior (HP:0000708): Atypical behavior is an abnormality in a person's actions that can be controlled or modulated by the will of the individual. While abnormal behaviors can be difficult to control, they are distinct from other abnormal actions that cannot be affected by the individual's will. Evidence: TAS. Frequency: Very frequent (HP:0040281). (ORPHA:77296)
- Abnormality of the endocrine system (HP:0000818): An abnormality of the endocrine system. Evidence: TAS. Frequency: Very frequent (HP:0040281). (ORPHA:77296)
- Obesity (HP:0001513): Accumulation of substantial excess body fat. Evidence: TAS. Frequency: Very frequent (HP:0040281). (ORPHA:77296)
- Headache (HP:0002315): Cephalgia, or pain sensed in various parts of the head, not confined to the area of distribution of any nerve. Evidence: TAS. Frequency: Very frequent (HP:0040281). (ORPHA:77296)
- Abnormal metabolism (HP:0032245): An abnormality in the function of the chemical reactions related to processes including conversion of food to enter, synthesis of proteins, lipids, nucleic acids, and carbohydrates, or the elimination of waste products. Evidence: TAS. Frequency: Very frequent (HP:0040281). (ORPHA:77296)
- Diabetes mellitus (HP:0000819): A group of abnormalities characterized by hyperglycemia and glucose intolerance. Evidence: TAS. Frequency: Frequent (HP:0040282). (ORPHA:77296)
- Hirsutism (HP:0001007): Abnormally increased hair growth referring to a male pattern of body hair (androgenic hair). Evidence: TAS. Frequency: Frequent (HP:0040282). (ORPHA:77296)
- Migraine (HP:0002076): Migraine is a chronic neurological disorder characterized by episodic attacks of headache and associated symptoms. Evidence: TAS. Frequency: Frequent (HP:0040282). (ORPHA:77296)
- Cerebral cortical atrophy (HP:0002120): Atrophy of the cortex of the cerebrum. Evidence: TAS. Frequency: Frequent (HP:0040282). (ORPHA:77296)
- Depression (HP:0000716): Frequently experiencing feelings of being down, miserable, and/or hopeless; struggling to recover from these moods; having a pessimistic outlook on the future; feeling a pervasive sense of shame; having a low self-worth; experiencing thoughts of suicide and engaging in suicidal behavior. Evidence: TAS. Frequency: Occasional (HP:0040283). (ORPHA:77296)
- Psychotic episodes (HP:0000725): Periods of time during which an individual experiences significant disturbances in their thoughts, perceptions, emotions, and behavior, resulting in a loss of touch with reality. These episodes are hallmark features of psychotic disorders such as schizophrenia, schizoaffective disorder, and certain forms of bipolar disorder. Evidence: TAS. Frequency: Occasional (HP:0040283). (ORPHA:77296)
- Abnormality of the thyroid gland (HP:0000820): An abnormality of the thyroid gland. Evidence: TAS. Frequency: Occasional (HP:0040283). (ORPHA:77296)
- Hypothyroidism (HP:0000821): Deficiency of thyroid hormone. Evidence: TAS. Frequency: Occasional (HP:0040283). (ORPHA:77296)
- Hypertension (HP:0000822): The presence of chronic increased pressure in the systemic arterial system. Evidence: TAS. Frequency: Occasional (HP:0040283). (ORPHA:77296)
- Osteoporosis (HP:0000939): Osteoporosis is a systemic skeletal disease characterized by low bone density and microarchitectural deterioration of bone tissue with a consequent increase in bone fragility. According to the WHO criteria, osteoporosis is defined as a BMD that lies 2.5 standard deviations or more below the average value for young healthy adults (a T-score below -2.5 SD). Evidence: TAS. Frequency: Occasional (HP:0040283). (ORPHA:77296)
- Acne (HP:0001061): A skin condition in which there is an increase in sebum secretion by the pilosebaceous apparatus associated with open comedones (blackheads), closed comedones (whiteheads), and pustular nodules (papules, pustules, and cysts). Evidence: TAS. Frequency: Occasional (HP:0040283). (ORPHA:77296)
- Seizure (HP:0001250): A seizure is an intermittent abnormality of nervous system physiology characterized by a transient occurrence of signs and/or symptoms due to abnormal excessive or synchronous neuronal activity in the brain. Evidence: TAS. Frequency: Occasional (HP:0040283). (ORPHA:77296)
- Brisk reflexes (HP:0001348): Tendon reflexes that are noticeably more active than usual (conventionally denoted 3+ on clinical examination). Brisk reflexes may or may not indicate a neurological lesion. They are distinguished from hyperreflexia by the fact that hyerreflexia is characterized by hyperactive repeating (clonic) reflexes, which are considered to be always abnormal. Evidence: TAS. Frequency: Occasional (HP:0040283). (ORPHA:77296)
- Hyperuricemia (HP:0002149): The concentration of uric acid in the blood circulation is above the upper limit of normal. Evidence: TAS. Frequency: Occasional (HP:0040283). (ORPHA:77296)
- Orofacial dyskinesia (HP:0002310). Evidence: TAS. Frequency: Occasional (HP:0040283). (ORPHA:77296)
- Vertigo (HP:0002321): An abnormal sensation of spinning while the body is actually stationary. Evidence: TAS. Frequency: Occasional (HP:0040283). (ORPHA:77296)
- Action tremor (HP:0002345): A tremor present when the limbs are active, either when outstretched in a certain position or throughout a voluntary movement. Evidence: TAS. Frequency: Occasional (HP:0040283). (ORPHA:77296)
- Memory impairment (HP:0002354): An impairment of memory as manifested by a reduced ability to remember things such as dates and names, and increased forgetfulness. Evidence: TAS. Frequency: Occasional (HP:0040283). (ORPHA:77296)
- Osteoarthritis (HP:0002758): Degeneration (wear and tear) of articular cartilage, i.e., of the joint surface. Joint degeneration may be accompanied by osteophytes (bone overgrowth), narrowing of the joint space, regions of sclerosis at the joint surface, or joint deformity. Evidence: TAS. Frequency: Occasional (HP:0040283). (ORPHA:77296)
- Hypercholesterolemia (HP:0003124): An increased concentration of cholesterol in the blood. Evidence: TAS. Frequency: Occasional (HP:0040283). (ORPHA:77296)
- Brain atrophy (HP:0012444): Partial or complete wasting (loss) of brain tissue that was once present. Evidence: TAS. Frequency: Occasional (HP:0040283). (ORPHA:77296)
- Suicidal ideation (HP:0031589): Frequent thoughts about or preoccupation with killing oneself. Evidence: TAS. Frequency: Occasional (HP:0040283). (ORPHA:77296)
- Cognitive impairment (HP:0100543): Abnormal cognition is characterized by deficits in thinking, reasoning, or remembering. Evidence: TAS. Frequency: Occasional (HP:0040283). (ORPHA:77296)
These phenotypes are associated with the disease Morgagni-Stewart-Morel syndrome (ORPHA:77296).